- Congenital onset (HP:0003577): A phenotypic abnormality that is present at birth. Evidence: PCS. Frequency: 3/3. (PMID:28065471)
- Hypsarrhythmia (HP:0002521): Hypsarrhythmia is abnormal interictal high amplitude waves and a background of irregular spikes. There is continuous (during wakefulness), high-amplitude (>200 Hz), generalized polymorphic slowing with no organized background and multifocal spikes demonstrated by electroencephalography (EEG). Evidence: PCS. Frequency: 1/1. (PMID:28065471)
- Inguinal hernia (HP:0000023): Protrusion of the contents of the abdominal cavity through the inguinal canal. Evidence: PCS. Frequency: 1/3. (PMID:28065471)
- Seizure (HP:0001250): A seizure is an intermittent abnormality of nervous system physiology characterized by a transient occurrence of signs and/or symptoms due to abnormal excessive or synchronous neuronal activity in the brain. Evidence: PCS. Frequency: 2/3. (PMID:28065471)
- Blepharophimosis (HP:0000581): A fixed reduction in the vertical distance between the upper and lower eyelids with short palpebral fissures. Evidence: PCS. Frequency: 1/3. (PMID:28065471)
- Hypotonia (HP:0001252): Hypotonia is an abnormally low muscle tone (the amount of tension or resistance to movement in a muscle). Even when relaxed, muscles have a continuous and passive partial contraction which provides some resistance to passive stretching. Hypotonia thus manifests as diminished resistance to passive stretching. Hypotonia is not the same as muscle weakness, although the two conditions can co-exist. Evidence: PCS. Frequency: 3/3. (PMID:28065471)
- Motor delay (HP:0001270): A type of Developmental delay characterized by a delay in acquiring motor skills. Evidence: PCS. Frequency: 1/1. (PMID:28065471)
- Thin corpus callosum (HP:0033725): An abnormally thin corpus callous, due to atrophy, hypoplasia or agenesis. This term is intended to be used in situations where it is not known if thinning of the corpus callosum (for instance, as visualized by magnetic resonance tomography) is due to abnormal development (e.g. a leukodystrophy) or atrophy following normal development (e.g. neurodegeneration). Evidence: PCS. Frequency: 1/3. (PMID:28065471)
- Cataract (HP:0000518): A cataract is an opacity or clouding that develops in the crystalline lens of the eye or in its capsule. Evidence: PCS. Frequency: 1/3. (PMID:28065471)
- Failure to thrive (HP:0001508): Failure to thrive (FTT) refers to a child whose physical growth is substantially below the norm. Evidence: PCS. Frequency: 1/1. (PMID:28065471)
- Ventricular septal defect (HP:0001629): A hole between the two bottom chambers (ventricles) of the heart. The defect is centered around the most superior aspect of the ventricular septum. Evidence: PCS. Frequency: 2/3. (PMID:28065471)
- Hypertelorism (HP:0000316): Interpupillary distance more than 2 SD above the mean (alternatively, the appearance of an increased interpupillary distance or widely spaced eyes). Evidence: PCS. Frequency: 2/3. (PMID:28065471)
- Single transverse palmar crease (HP:0000954): The distal and proximal transverse palmar creases are merged into a single transverse palmar crease. Evidence: PCS. Frequency: 1/3. (PMID:28065471)
- Bulbous nose (HP:0000414): Increased volume and globular shape of the anteroinferior aspect of the nose. Evidence: PCS. Frequency: 1/1. (PMID:28065471)
- Ventriculomegaly (HP:0002119): An increase in size of the ventricular system of the brain. Evidence: PCS. Frequency: 1/1. (PMID:28065471)
- Protruding ear (HP:0000411): Angle formed by the plane of the ear and the mastoid bone greater than the 97th centile for age (objective); or, outer edge of the helix more than 2 cm from the mastoid at the point of maximum distance (objective). Evidence: IEA. (OMIM:617403)
- Retrognathia (HP:0000278): An abnormality in which the mandible is mislocalised posteriorly. Evidence: IEA. (OMIM:617403)
- Simple ear (HP:0020206): The pinna has fewer folds and grooves than usual. Evidence: PCS. Frequency: 1/3. (PMID:28065471)
- Cutis laxa (HP:0000973): Wrinkled, redundant, inelastic and sagging skin. Evidence: PCS. Frequency: 3/3. (PMID:28065471)
- Kyphoscoliosis (HP:0002751): An abnormal curvature of the spine in both a coronal (lateral) and sagittal (back-to-front) plane. Evidence: PCS. Frequency: 0/3. (PMID:28065471)
- Downslanted palpebral fissures (HP:0000494): The palpebral fissure inclination is more than two standard deviations below the mean. Evidence: PCS. Frequency: 1/3. (PMID:28065471)
- Hip dysplasia (HP:0001385): The presence of developmental dysplasia of the hip. Evidence: PCS. Frequency: 1/3. (PMID:28065471)
- Micropenis (HP:0000054): Abnormally small penis. At birth, the normal penis is about 3 cm (stretched length from pubic tubercle to tip of penis) with micropenis less than 2.0-2.5 cm. Evidence: PCS. Frequency: 1/3. (PMID:28065471)
- Delayed speech and language development (HP:0000750): A degree of language development that is significantly below the norm for a child of a specified age. Evidence: PCS. Frequency: 1/1. (PMID:28065471)
- Talipes equinovarus (HP:0001762): Talipes equinovarus (also called clubfoot) typically has four main components: inversion and adduction of the forefoot; inversion of the heel and hindfoot; equinus (limitation of extension) of the ankle and subtalar joint; and internal rotation of the leg. Evidence: PCS. Frequency: 1/3. (PMID:28065471)
- Wide nasal bridge (HP:0000431): Increased breadth of the nasal bridge (and with it, the nasal root). Evidence: PCS. Frequency: 2/3. (PMID:28065471)
- Mask-like facies (HP:0000298): A lack of facial expression often with staring eyes and a slightly open mouth. Evidence: PCS. Frequency: 2/3. (PMID:28065471)
- Ascending tubular aorta aneurysm (HP:0004970): An abnormal localized widening (dilatation) of the tubular part of the ascending aorta. Evidence: PCS. Frequency: 1/3. (PMID:28065471)
- Redundant skin (HP:0001582): Loose and sagging skin often associated with loss of skin elasticity. Evidence: PCS. Frequency: 3/3. (PMID:28065471)
- Gliosis (HP:0002171): Gliosis is the focal proliferation of glial cells in the central nervous system. Evidence: PCS. Frequency: 1/1. (PMID:28065471)
- Camptodactyly (HP:0012385): The distal interphalangeal joint and/or the proximal interphalangeal joint of the fingers or toes cannot be extended to 180 degrees by either active or passive extension. Evidence: PCS. Frequency: 1/1. (PMID:28065471)
- Joint contracture (HP:0034392): A limitation in the passive range of motion of a joint resulting from loss of elasticity in the periarticular tissues owing to structural changes of non-bony tissues, such as muscles, tendons, ligaments, joint capsules or skin. A contracture prevents movement of the associated body part. Evidence: PCS. Frequency: 1/3. (PMID:28065471)
- Disproportionate tall stature (HP:0001519): A tall and slim body build with increased arm span to height ratio (>1.05) and a reduced upper-to-lower segment ratio (<0.85), i.e., unusually long arms and legs. The extremities as well as the hands and feet are unusually slim. Evidence: PCS. Frequency: 1/3. (PMID:28065471)
- Hypertrophic cardiomyopathy (HP:0001639): Hypertrophic cardiomyopathy (HCM) is defined by the presence of increased ventricular wall thickness or mass in the absence of loading conditions (hypertension, valve disease) sufficient to cause the observed abnormality. Evidence: PCS. Frequency: 1/3. (PMID:28065471)
- Hip dislocation (HP:0002827): Displacement of the femur from its normal location in the hip joint. Evidence: PCS. Frequency: 2/3. (PMID:28065471)
- Autosomal recessive inheritance (HP:0000007): A mode of inheritance that is observed for traits related to a gene encoded on one of the autosomes (i.e., the human chromosomes 1-22) in which a trait manifests in individuals with two pathogenic alleles, either homozygotes (two copies of the same mutant allele) or compound heterozygotes (whereby each copy of a gene has a distinct mutant allele). Evidence: PCS. (PMID:28065471)
- Congestive heart failure (HP:0001635): The presence of an abnormality of cardiac function that is responsible for the failure of the heart to pump blood at a rate that is commensurate with the needs of the tissues or a state in which abnormally elevated filling pressures are required for the heart to do so. Heart failure is frequently related to a defect in myocardial contraction. Evidence: PCS. Frequency: 1/3. (PMID:28065471)
- Reduced subcutaneous adipose tissue (HP:0003758): A reduced amount of fat tissue in the lowest layer of the integument. This feature can be appreciated by a reduced skinfold thickness. Evidence: PCS. Frequency: 3/3. (PMID:28065471)
- Aortic tortuosity (HP:0006687): Abnormal tortuous (i.e., twisted) form of the aorta. Evidence: PCS. Frequency: 1/3. (PMID:28065471)
- Macrotia (HP:0000400): Median longitudinal ear length greater than two standard deviations above the mean and median ear width greater than two standard deviations above the mean (objective); or, apparent increase in length and width of the pinna (subjective). Evidence: PCS. Frequency: 1/1. (PMID:28065471)
- Narrow naris (HP:0009933): Slender, slit-like aperture of the nostril. Evidence: PCS. Frequency: 2/3. (PMID:28065471)
- Atrial septal defect (HP:0001631): Atrial septal defect (ASD) is a congenital abnormality of the interatrial septum that enables blood flow between the left and right atria via the interatrial septum. Evidence: PCS. Frequency: 1/3. (PMID:28065471)
- Bilateral cryptorchidism (HP:0008689): Absence of both testes from the scrotum owing to failure of the testis or testes to descend through the inguinal canal to the scrotum. Evidence: PCS. Frequency: 2/4. (PMID:28065471)
- Cryptorchidism (HP:0000028): Testis in inguinal canal. That is, absence of one or both testes from the scrotum owing to failure of the testis or testes to descend through the inguinal canal to the scrotum. Evidence: PCS. Frequency: 1/3. (PMID:28065471)
- Low-set ears (HP:0000369): Upper insertion of the ear to the scalp below an imaginary horizontal line drawn between the inner canthi of the eye and extending posteriorly to the ear. Evidence: PCS. Frequency: 2/3. (PMID:28065471)
- Triangular face (HP:0000325): Facial contour, as viewed from the front, triangular in shape, with breadth at the temples and tapering to a narrow chin. Evidence: PCS. Frequency: 2/3. (PMID:28065471)
- Entropion (HP:0000621): An abnormal inversion (turning inward) of the eyelid (usually the lower) towards the globe. Entropion is usually acquired as a result of involutional or cicatricial processes but may occasionally be congenital. Evidence: PCS. Frequency: 2/3. (PMID:28065471)
These phenotypes are associated with the disease autosomal recessive cutis laxa type 2D (OMIM:617403).